- Spicular pigmentation of the retina (HP:0007737): Pigment migration into the retina in a bone-spicule configuration (resembling the nucleated cells within the lacuna of bone). Evidence: PCS. Frequency: 1/1. (PMID:24670872)
- Nyctalopia (HP:0000662): Inability to see well at night or in poor light. Evidence: PCS. Frequency: 1/1. Onset: Childhood onset (HP:0011463). (PMID:24670872)
- Visual field defect (HP:0001123). Evidence: PCS. Frequency: 1/1. Onset: Childhood onset (HP:0011463). (PMID:24670872)
- Childhood onset (HP:0011463): Onset of disease at the age of between 1 and 5 years. Evidence: PCS. Frequency: 1/1. (PMID:24670872)
- Autosomal recessive inheritance (HP:0000007): A mode of inheritance that is observed for traits related to a gene encoded on one of the autosomes (i.e., the human chromosomes 1-22) in which a trait manifests in individuals with two pathogenic alleles, either homozygotes (two copies of the same mutant allele) or compound heterozygotes (whereby each copy of a gene has a distinct mutant allele). Evidence: PCS. (PMID:24670872)
- Reduced visual acuity (HP:0007663). Evidence: PCS. Frequency: 1/1. (PMID:24670872)
- Rod-cone dystrophy (HP:0000510): An inherited retinal disease subtype in which the rod photoreceptors appear to be more severely affected than the cone photoreceptors. Typical presentation is with nyctalopia (due to rod dysfunction) followed by loss of mid-peripheral field of vision, which gradually extends and leaves many patients with a small central island of vision due to the preservation of macular cones. Evidence: PCS. Frequency: 1/1. (PMID:24670872)
- Retinal atrophy (HP:0001105): A nonspecific term denoting wasting, especially as a result of degeneration, of the retinal pigment epithelium (RPE) and neurosensory retinal cells. Evidence: PCS. Frequency: 1/1. (PMID:24670872)
These phenotypes are associated with the disease retinitis pigmentosa 68 (OMIM:615725).